- Bilateral tonic-clonic seizure (HP:0002069): A bilateral tonic-clonic seizure is a seizure defined by a tonic (bilateral increased tone, lasting seconds to minutes) and then a clonic (bilateral sustained rhythmic jerking) phase. Evidence: PCS. Frequency: 7/9. (PMID:17431681)
- Juvenile onset (HP:0003621): Onset of signs or symptoms of disease between the age of 5 and 15 years. Evidence: PCS. Frequency: 8/8. (PMID:17431681)
- Generalized myoclonic seizure (HP:0002123): A generalized myoclonic seizure is a type of generalized motor seizure characterized by bilateral, sudden, brief (<100 ms) involuntary single or multiple contraction of muscles or muscle groups of variable topography (axial, proximal limb, distal). Myoclonus is less regularly repetitive and less sustained than is clonus. Evidence: PCS. Frequency: 9/9. (PMID:17431681)
- Febrile seizure (within the age range of 3 months to 6 years) (HP:0002373): A febrile seizure is any type of seizure (most often a generalized tonic-clonic seizure) occurring with fever (at least 38 degrees Celsius) but in the absence of central nervous system infection, severe metabolic disturbance or other alternative precipitant in children between the ages of 3 months and 6 years. Evidence: PCS. Frequency: 0/8. (PMID:17431681)
- Generalized non-motor (absence) seizure (HP:0002121): A generalized non-motor (absence) seizure is a type of a type of dialeptic seizure that is of electrographically generalized onset. It is a generalized seizure characterized by an interruption of activities, a blank stare, and usually the person will be unresponsive when spoken to. Any ictal motor phenomena are minor in comparison to these non-motor features. Evidence: PCS. Frequency: 0/8. (PMID:17431681)
- EEG with polyspike wave complexes (HP:0002392): The presence of complexes of repetitive spikes and waves in EEG. Evidence: PCS. Frequency: 6/8. (PMID:17431681)
- Autosomal dominant inheritance (HP:0000006): A mode of inheritance that is observed for traits related to a gene encoded on one of the autosomes (i.e., the human chromosomes 1-22) in which a trait manifests in heterozygotes. In the context of medical genetics, an autosomal dominant disorder is caused when a single copy of the mutant allele is present. Males and females are affected equally, and can both transmit the disorder with a risk of 50% for each child of inheriting the mutant allele. Evidence: PCS. (PMID:17431681)
These phenotypes are associated with the disease myoclonic epilepsy, juvenile, susceptibility to, 4 (OMIM:611364).